- Vertigo (HP:0002321): An abnormal sensation of spinning while the body is actually stationary. Evidence: IEA. (OMIM:611907)
- Episodic ataxia (HP:0002131): Periodic spells of incoordination and imbalance, that is, episodes of ataxia typically lasting from 10 minutes to several hours or days. Evidence: IEA. (OMIM:611907)
- Dysarthria (HP:0001260): Dysarthric speech is a general description referring to a neurological speech disorder characterized by poor articulation. Depending on the involved neurological structures, dysarthria may be further classified as spastic, flaccid, ataxic, hyperkinetic and hypokinetic, or mixed. Evidence: IEA. (OMIM:611907)
- Muscle weakness (HP:0001324): Reduced strength of muscles. Evidence: IEA. (OMIM:611907)
- Autosomal dominant inheritance (HP:0000006): A mode of inheritance that is observed for traits related to a gene encoded on one of the autosomes (i.e., the human chromosomes 1-22) in which a trait manifests in heterozygotes. In the context of medical genetics, an autosomal dominant disorder is caused when a single copy of the mutant allele is present. Males and females are affected equally, and can both transmit the disorder with a risk of 50% for each child of inheriting the mutant allele. Evidence: IEA. (OMIM:611907)
These phenotypes are associated with the disease episodic ataxia type 7 (OMIM:611907).